- Juvenile onset (HP:0003621): Onset of signs or symptoms of disease between the age of 5 and 15 years. Evidence: PCS. Frequency: 5/5. (PMID:24891338)
- High myopia (HP:0011003): A severe form of myopia with greater than -6.00 diopters. Evidence: PCS. Frequency: 5/5. (PMID:24891338)
- Autosomal dominant inheritance (HP:0000006): A mode of inheritance that is observed for traits related to a gene encoded on one of the autosomes (i.e., the human chromosomes 1-22) in which a trait manifests in heterozygotes. In the context of medical genetics, an autosomal dominant disorder is caused when a single copy of the mutant allele is present. Males and females are affected equally, and can both transmit the disorder with a risk of 50% for each child of inheriting the mutant allele. Evidence: PCS. (PMID:24891338)
These phenotypes are associated with the disease myopia 24, autosomal dominant (OMIM:615946).